- Joint stiffness (HP:0001387): Joint stiffness is a perceived sensation of tightness in a joint or joints when attempting to move them after a period of inactivity. Joint stiffness typically subsides over time. Evidence: TAS. Frequency: Very frequent (HP:0040281). (ORPHA:1822)
- Pes planus (HP:0001763): A foot where the longitudinal arch of the foot is in contact with the ground or floor when the individual is standing; or, in a patient lying supine, a foot where the arch is in contact with the surface of a flat board pressed against the sole of the foot by the examiner with a pressure similar to that expected from weight bearing; or, the height of the arch is reduced. Evidence: TAS. Frequency: Very frequent (HP:0040281). (ORPHA:1822)
- Bone pain (HP:0002653): An unpleasant sensation characterized by physical discomfort (such as pricking, throbbing, or aching) localized to bone. Evidence: TAS. Frequency: Very frequent (HP:0040281). (ORPHA:1822)
- Recurrent fractures (HP:0002757): The repeated occurrence of bone fractures (implying an abnormally increased tendency for fracture). Evidence: TAS. Frequency: Occasional (HP:0040283). (ORPHA:1822)
- Osteoarthritis (HP:0002758): Degeneration (wear and tear) of articular cartilage, i.e., of the joint surface. Joint degeneration may be accompanied by osteophytes (bone overgrowth), narrowing of the joint space, regions of sclerosis at the joint surface, or joint deformity. Evidence: TAS. Frequency: Very frequent (HP:0040281). (ORPHA:1822)
- Abnormal femur morphology (HP:0002823): Any anomaly of the structure of the femur. Evidence: TAS. Frequency: Occasional (HP:0040283). (ORPHA:1822)
- Genu valgum (HP:0002857): The legs angle inward, such that the knees are close together and the ankles far apart. Evidence: TAS. Frequency: Frequent (HP:0040282). (ORPHA:1822)
- Genu varum (HP:0002970): A positional abnormality marked by outward bowing of the legs in which the knees stay wide apart when a person stands with the feet and ankles together. Evidence: TAS. Frequency: Frequent (HP:0040282). (ORPHA:1822)
- Abnormal femoral neck morphology (HP:0003367): An abnormality of the femoral neck (which is the process of bone, connecting the femoral head with the femoral shaft). Evidence: TAS. Frequency: Occasional (HP:0040283). (ORPHA:1822)
- Accelerated skeletal maturation (HP:0005616): An abnormally increased rate of skeletal maturation. Accelerated skeletal maturation can be diagnosed on the basis of an estimation of the bone age from radiographs of specific bones in the human body. Evidence: TAS. Frequency: Very frequent (HP:0040281). (ORPHA:1822)
- Abnormal epiphysis morphology (HP:0005930): An anomaly of epiphysis, which is the expanded articular end of a long bone that developes from a secondary ossification center, and which during the period of growth is either entirely cartilaginous or is separated from the shaft by a cartilaginous disk. Evidence: TAS. Frequency: Very frequent (HP:0040281). (ORPHA:1822)
- Tarsal synostosis (HP:0008368): Synostosis (bony fusion) involving one or more bones of the tarsus (calcaneus, talus, cuboid, navicular, cuneiiform bones). Evidence: TAS. Frequency: Very frequent (HP:0040281). (ORPHA:1822)
- Flattened femoral head (HP:0008812): An abnormally flattened femoral head. Evidence: TAS. Frequency: Occasional (HP:0040283). (ORPHA:1822)
- Irregular epiphyses (HP:0010582): An alteration of the normally smooth contour of the epiphysis leading to an irregular appearance. Evidence: TAS. Frequency: Very frequent (HP:0040281). (ORPHA:1822)
- Asymmetric growth (HP:0100555): A growth pattern that displays an abnormal difference between the left and the right side. Evidence: TAS. Frequency: Very frequent (HP:0040281). (ORPHA:1822)
- Exostoses (HP:0100777): An exostosis is a benign growth the projects outward from the bone surface. It is capped by cartilage, and arises from a bone that develops from cartilage. Evidence: TAS. Frequency: Very frequent (HP:0040281). (ORPHA:1822)
These phenotypes are associated with the disease Dysplasia epiphysealis hemimelica (ORPHA:1822).